Phenotypes associated with the disease autosomal dominant nonsyndromic hearing loss 9 (OMIM:601369):
- Abnormal vestibulocochlear nerve morphology (HP:0009591): Any structural anomaly of the vestibulocochlear nerve. The vestibulocochlear nerve consists of the vestibular and cochlear nerves, also known as cranial nerve eight (CN VIII). Each nerve has distinct nuclei within the brainstem. The vestibular nerve is primarily responsible for maintaining body balance and eye movements, while the cochlear nerve is responsible for hearing. Evidence: TAS. (OMIM:601369)
- Progressive (HP:0003676): Applies to a disease manifestation that increases in scope or severity over the course of time, i.e., that worsens with age. Evidence: PCS. (PMID:9806553)
- Vertigo (HP:0002321): An abnormal sensation of spinning while the body is actually stationary. Evidence: TAS. (OMIM:601369)
- Cochlear degeneration (HP:0005102): Deterioration or loss of the tissues of the cochlea. Evidence: TAS. (OMIM:601369)
- Postlingual sensorineural hearing impairment (HP:0008596): A form of sensorineural hearing impairment with onset after the acquisition of speech. Evidence: PCS. (PMID:9806553)
- Young adult onset (HP:0011462): Onset of disease at the age of between 16 and 40 years. Evidence: PCS. (PMID:9806553)
- Tinnitus (HP:0000360): Tinnitus is an auditory perception that can be described as the experience of sound, in the ear or in the head, in the absence of external acoustic stimulation. Evidence: TAS. (OMIM:601369)
- Autosomal dominant inheritance (HP:0000006): A mode of inheritance that is observed for traits related to a gene encoded on one of the autosomes (i.e., the human chromosomes 1-22) in which a trait manifests in heterozygotes. In the context of medical genetics, an autosomal dominant disorder is caused when a single copy of the mutant allele is present. Males and females are affected equally, and can both transmit the disorder with a risk of 50% for each child of inheriting the mutant allele. Evidence: PCS. (PMID:9806553)